- Amenorrhea (HP:0000141): Absence of menses for an interval of time equivalent to a total of more than (or equal to) 3 previous cycles or 6 months. Evidence: IEA. (OMIM:184700)
- Abnormality of metabolism/homeostasis (HP:0001939). Evidence: IEA. (OMIM:184700)
- Enlarged polycystic ovaries (HP:0008675). Evidence: IEA. (OMIM:184700)
- Oligomenorrhea (HP:0000876): Infrequent menses (less than 6 per year or more than 35 days between cycles). Evidence: IEA. (OMIM:184700)
- Autosomal dominant inheritance (HP:0000006): A mode of inheritance that is observed for traits related to a gene encoded on one of the autosomes (i.e., the human chromosomes 1-22) in which a trait manifests in heterozygotes. In the context of medical genetics, an autosomal dominant disorder is caused when a single copy of the mutant allele is present. Males and females are affected equally, and can both transmit the disorder with a risk of 50% for each child of inheriting the mutant allele. Evidence: IEA. (OMIM:184700)
- Hirsutism (HP:0001007): Abnormally increased hair growth referring to a male pattern of body hair (androgenic hair). Evidence: TAS. (OMIM:184700)
- Obesity (HP:0001513): Accumulation of substantial excess body fat. Evidence: IEA. (OMIM:184700)
These phenotypes are associated with the disease polycystic ovary syndrome (OMIM:184700).